Phenotypes associated with the disease major affective disorder 1 (OMIM:125480):
- Mania (HP:0100754): A state of abnormally elevated or irritable mood, arousal, and/or energy levels. Evidence: TAS. (OMIM:125480)
- Depression (HP:0000716): Frequently experiencing feelings of being down, miserable, and/or hopeless; struggling to recover from these moods; having a pessimistic outlook on the future; feeling a pervasive sense of shame; having a low self-worth; experiencing thoughts of suicide and engaging in suicidal behavior. Evidence: TAS. (OMIM:125480)
- Autosomal dominant inheritance (HP:0000006): A mode of inheritance that is observed for traits related to a gene encoded on one of the autosomes (i.e., the human chromosomes 1-22) in which a trait manifests in heterozygotes. In the context of medical genetics, an autosomal dominant disorder is caused when a single copy of the mutant allele is present. Males and females are affected equally, and can both transmit the disorder with a risk of 50% for each child of inheriting the mutant allele. Evidence: TAS. (OMIM:125480)